Phenotypes associated with the disease autosomal recessive nonsyndromic hearing loss 77 (OMIM:613079):
- Bilateral sensorineural hearing impairment (HP:0008619): A form of sensorineural hearing impairment that affects both ears. Evidence: PCS. Frequency: 7/7. Onset: Childhood onset (HP:0011463). (PMID:19732867)
- Abnormal vestibular function (HP:0001751): An abnormality of the functioning of the vestibular apparatus. Evidence: PCS. Frequency: 0/7. (PMID:19732867)
- Tinnitus (HP:0000360): Tinnitus is an auditory perception that can be described as the experience of sound, in the ear or in the head, in the absence of external acoustic stimulation. Evidence: PCS. Frequency: 0/7. (PMID:19732867)
- Autosomal recessive inheritance (HP:0000007): A mode of inheritance that is observed for traits related to a gene encoded on one of the autosomes (i.e., the human chromosomes 1-22) in which a trait manifests in individuals with two pathogenic alleles, either homozygotes (two copies of the same mutant allele) or compound heterozygotes (whereby each copy of a gene has a distinct mutant allele). Evidence: PCS. (PMID:19732867)